- Microcephaly (HP:0000252): Head circumference below 2 standard deviations below the mean for age and gender. Evidence: TAS. Frequency: Very frequent (HP:0040281). (ORPHA:1824)
- Astigmatism (HP:0000483): A type of refraction error associated with abnormal curvatures on the anterior and/or posterior surface of the cornea. Evidence: TAS. Frequency: Occasional (HP:0040283). (ORPHA:1824)
- Visual impairment (HP:0000505): Visual impairment (or vision impairment) is vision loss (of a person) to such a degree as to qualify as an additional support need through a significant limitation of visual capability resulting from either disease, trauma, or congenital or degenerative conditions that cannot be corrected by conventional means, such as refractive correction, medication, or surgery. Evidence: TAS. Frequency: Occasional (HP:0040283). (ORPHA:1824)
- Nystagmus (HP:0000639): Rhythmic, involuntary oscillations of one or both eyes related to abnormality in fixation, conjugate gaze, or vestibular mechanisms. Evidence: TAS. Frequency: Frequent (HP:0040282). (ORPHA:1824)
- Platyspondyly (HP:0000926): A flattened vertebral body shape with reduced distance between the vertebral endplates. Evidence: TAS. Frequency: Occasional (HP:0040283). (ORPHA:1824)
- Brachydactyly (HP:0001156): Digits that appear disproportionately short compared to the hand/foot. The word brachydactyly is used here to describe a series distinct patterns of shortened digits (brachydactyly types A-E). This is the sense used here. Evidence: TAS. Frequency: Occasional (HP:0040283). (ORPHA:1824)
- Intellectual disability (HP:0001249): The term intellectual disability or intellectual developmental disorder is used to describe significantly sub-average intellectual and adaptive functioning based on clinical assessment and as measured by individually administered, appropriately normed, standardized and validated tests of intellectual functioning and adaptive behavior, with onset during the developmental period from infancy through adolescence. Evidence: TAS. Frequency: Frequent (HP:0040282). (ORPHA:1824)
- Joint stiffness (HP:0001387): Joint stiffness is a perceived sensation of tightness in a joint or joints when attempting to move them after a period of inactivity. Joint stiffness typically subsides over time. Evidence: TAS. Frequency: Occasional (HP:0040283). (ORPHA:1824)
- Epiphyseal dysplasia (HP:0002656). Evidence: TAS. Frequency: Very frequent (HP:0040281). (ORPHA:1824)
- Delayed skeletal maturation (HP:0002750): A decreased rate of skeletal maturation. Delayed skeletal maturation can be diagnosed on the basis of an estimation of the bone age from radiographs of specific bones in the human body. Evidence: TAS. Frequency: Occasional (HP:0040283). (ORPHA:1824)
- Coxa vara (HP:0002812): Coxa vara includes all forms of decrease of the femoral neck shaft angle (the angle between the neck and the shaft of the femur) to less than 120 degrees. Evidence: TAS. Frequency: Frequent (HP:0040282). (ORPHA:1824)
- Arthralgia (HP:0002829): Joint pain. Evidence: TAS. Frequency: Frequent (HP:0040282). (ORPHA:1824)
- Patellar dislocation (HP:0002999): The kneecap normally is located within the groove termed trochlea on the distal femur and can slide up and down in it. Patellar dislocation occurs if the patella fully dislocates out of the groove. Evidence: TAS. Frequency: Occasional (HP:0040283). (ORPHA:1824)
- Elbow dislocation (HP:0003042): Dislocation of the distal humerus out of the elbow joint, where the radius, ulna, and humerus meet. Evidence: TAS. Frequency: Occasional (HP:0040283). (ORPHA:1824)
- Dislocated radial head (HP:0003083): A dislocation of the head of the radius from its socket in the elbow joint. Evidence: TAS. Frequency: Occasional (HP:0040283). (ORPHA:1824)
- Short stature (HP:0004322): A height below that which is expected according to age and gender norms. Although there is no universally accepted definition of short stature, many refer to "short stature" as height more than 2 standard deviations below the mean for age and gender (or below the 3rd percentile for age and gender dependent norms). Evidence: TAS. Frequency: Very frequent (HP:0040281). (ORPHA:1824)
- Abnormal epiphysis morphology (HP:0005930): An anomaly of epiphysis, which is the expanded articular end of a long bone that developes from a secondary ossification center, and which during the period of growth is either entirely cartilaginous or is separated from the shaft by a cartilaginous disk. Evidence: TAS. Frequency: Very frequent (HP:0040281). (ORPHA:1824)
- Aplasia/Hypoplasia of the corpus callosum (HP:0007370): Absence or underdevelopment of the corpus callosum. Evidence: TAS. Frequency: Occasional (HP:0040283). (ORPHA:1824)
- Abnormal retinal pigmentation (HP:0007703): Any deviation from the normal pigmentation of the retina. Evidence: TAS. Frequency: Frequent (HP:0040282). (ORPHA:1824)
- Irregular epiphyses (HP:0010582): An alteration of the normally smooth contour of the epiphysis leading to an irregular appearance. Evidence: TAS. Frequency: Very frequent (HP:0040281). (ORPHA:1824)
- Abnormality of nail color (HP:0100643): An anomaly of the color of the nail. Evidence: TAS. Frequency: Occasional (HP:0040283). (ORPHA:1824)
These phenotypes are associated with the disease Lowry-Wood syndrome (ORPHA:1824).